Phenotypes associated with the disease Paroxysmal exertion-induced dyskinesia (ORPHA:98811):
- Choreoathetosis (HP:0001266): Involuntary movements characterized by both athetosis (inability to sustain muscles in a fixed position) and chorea (widespread jerky arrhythmic movements). Evidence: TAS. Frequency: Very frequent (HP:0040281). (ORPHA:98811)
- Dystonia (HP:0001332): An abnormally increased muscular tone that causes fixed abnormal postures. There is a slow, intermittent twisting motion that leads to exaggerated turning and posture of the extremities and trunk. Evidence: TAS. Frequency: Very frequent (HP:0040281). (ORPHA:98811)
- Paroxysmal dyskinesia (HP:0007166): Episodic bouts of involuntary movements with dystonic, choreic, ballistic movements, or a combination thereof. There is no loss of consciousness during the attacks. Evidence: TAS. Frequency: Very frequent (HP:0040281). (ORPHA:98811)
- Intellectual disability (HP:0001249): The term intellectual disability or intellectual developmental disorder is used to describe significantly sub-average intellectual and adaptive functioning based on clinical assessment and as measured by individually administered, appropriately normed, standardized and validated tests of intellectual functioning and adaptive behavior, with onset during the developmental period from infancy through adolescence. Evidence: TAS. Frequency: Frequent (HP:0040282). (ORPHA:98811)
- Seizure (HP:0001250): A seizure is an intermittent abnormality of nervous system physiology characterized by a transient occurrence of signs and/or symptoms due to abnormal excessive or synchronous neuronal activity in the brain. Evidence: TAS. Frequency: Frequent (HP:0040282). (ORPHA:98811)
- Torsion dystonia (HP:0001304): Sustained involuntary muscle contractions that produce twisting and repetitive movements of the body. Evidence: TAS. Frequency: Frequent (HP:0040282). (ORPHA:98811)
- Generalized non-motor (absence) seizure (HP:0002121): A generalized non-motor (absence) seizure is a type of a type of dialeptic seizure that is of electrographically generalized onset. It is a generalized seizure characterized by an interruption of activities, a blank stare, and usually the person will be unresponsive when spoken to. Any ictal motor phenomena are minor in comparison to these non-motor features. Evidence: TAS. Frequency: Frequent (HP:0040282). (ORPHA:98811)
- Paresthesia (HP:0003401): Abnormal sensations such as tingling, pricking, or numbness of the skin with no apparent physical cause. Evidence: TAS. Frequency: Frequent (HP:0040282). (ORPHA:98811)
- Involuntary movements (HP:0004305): Involuntary contractions of muscle leading to involuntary movements of extremities, neck, trunk, or face. Evidence: TAS. Frequency: Frequent (HP:0040282). (ORPHA:98811)
- Hyperactive deep tendon reflexes (HP:0006801). Evidence: TAS. Frequency: Frequent (HP:0040282). (ORPHA:98811)
- Aggressive behavior (HP:0000718): Behavior or an act aimed at harming a person, animal, or physical property (e.g., acts of physical violence; shouting, swearing, and using harsh language; slashing someone's tires). Evidence: TAS. Frequency: Occasional (HP:0040283). (ORPHA:98811)
- Irritability (HP:0000737): An emotional state characterized by negative feelings of heightened frustration, annoyance, or feeling upset, often triggered by internal factors (e.g., fatigue, hunger, unfulfilled desires) or external factors (e.g., social or environmental challenges). Irritability may be unpredictable, and is accompanied by a lowered threshold for emotional reactivity and observable features (speech, facial expressions, or psychomotor activity). Evidence: TAS. Frequency: Occasional (HP:0040283). (ORPHA:98811)
- Ataxia (HP:0001251): Ataxia refers to impaired coordination of voluntary muscle movement. Cerebellar ataxia refers to ataxia due to dysfunction of the cerebellum. This causes a variety of elementary neurological deficits including asynergy (lack of coordination between muscles, limbs and joints), dysmetria (lack of ability to judge distances that can lead to under- or overshoot in grasping movements), and dysdiadochokinesia (inability to perform rapid movements requiring antagonizing muscle groups to be switched on and off repeatedly). Evidence: TAS. Frequency: Occasional (HP:0040283). (ORPHA:98811)
- Specific learning disability (HP:0001328): Impairment of certain skills such as reading or writing, coordination, self-control, or attention that interfere with the ability to learn. The impairment is not related to a global deficiency of intelligence. Evidence: TAS. Frequency: Occasional (HP:0040283). (ORPHA:98811)
- Chorea (HP:0002072): Chorea (Greek for 'dance') refers to widespread arrhythmic involuntary movements of a forcible, jerky and restless fashion. It is a random-appearing sequence of one or more discrete involuntary movements or movement fragments. Movements appear random because of variability in timing, duration or location. Each movement may have a distinct start and end. However, movements may be strung together and thus may appear to flow randomly from one muscle group to another. Chorea can involve the trunk, neck, face, tongue, and extremities. Evidence: TAS. Frequency: Occasional (HP:0040283). (ORPHA:98811)
- Mild intellectual disability (HP:0001256): Mild intellectual disability (ID) is defined as a type of ID characterized by mildly sub-average adaptive functioning and intellectual functioning, with an intelligence quotient (IQ) the range of 50-69. Evidence: TAS. Frequency: Very rare (HP:0040284). (ORPHA:98811)
- Lower limb spasticity (HP:0002061): Spasticity (velocity-dependent increase in tonic stretch reflexes with increased muscle tone and hyperexcitable tendon reflexes) in the muscles of the lower limbs, hips, and pelvis. Evidence: TAS. Frequency: Very rare (HP:0040284). (ORPHA:98811)